- Abnormality of the nervous system (HP:0000707): An abnormality of the nervous system. Evidence: TAS. Frequency: Very frequent (HP:0040281). (ORPHA:466650)
- Malignant hyperthermia (HP:0002047): Malignant hyperthermia is characterized by a rapid increase in temperature to 39-42 degrees C. Malignant hyperthermia may occur in response to either inhalational anesthetics such as halothane, to muscle relaxants such as succinylcholine, or to exercise. Evidence: TAS. Frequency: Very frequent (HP:0040281). (ORPHA:466650)
- Nausea (HP:0002018): A sensation of unease in the stomach together with an urge to vomit. Evidence: TAS. Frequency: Frequent (HP:0040282). (ORPHA:466650)
- Headache (HP:0002315): Cephalgia, or pain sensed in various parts of the head, not confined to the area of distribution of any nerve. Evidence: TAS. Frequency: Frequent (HP:0040282). (ORPHA:466650)
- Vertigo (HP:0002321): An abnormal sensation of spinning while the body is actually stationary. Evidence: TAS. Frequency: Frequent (HP:0040282). (ORPHA:466650)
- Tachypnea (HP:0002789): Very rapid breathing. Evidence: TAS. Frequency: Frequent (HP:0040282). (ORPHA:466650)
- Sinus tachycardia (HP:0011703): Heart rate of greater than 100 beats per minute. Evidence: TAS. Frequency: Frequent (HP:0040282). (ORPHA:466650)
- Fatigue (HP:0012378): A subjective feeling of tiredness characterized by a lack of energy and motivation. Evidence: TAS. Frequency: Frequent (HP:0040282). (ORPHA:466650)
- Abnormal pulse pressure (HP:0030850): An anomaly of the pulse pressure, which is defined as the systolic pressured minus the diastolic pressure. Evidence: TAS. Frequency: Frequent (HP:0040282). (ORPHA:466650)
- Seizure (HP:0001250): A seizure is an intermittent abnormality of nervous system physiology characterized by a transient occurrence of signs and/or symptoms due to abnormal excessive or synchronous neuronal activity in the brain. Evidence: TAS. Frequency: Occasional (HP:0040283). (ORPHA:466650)
- Ataxia (HP:0001251): Ataxia refers to impaired coordination of voluntary muscle movement. Cerebellar ataxia refers to ataxia due to dysfunction of the cerebellum. This causes a variety of elementary neurological deficits including asynergy (lack of coordination between muscles, limbs and joints), dysmetria (lack of ability to judge distances that can lead to under- or overshoot in grasping movements), and dysdiadochokinesia (inability to perform rapid movements requiring antagonizing muscle groups to be switched on and off repeatedly). Evidence: TAS. Frequency: Occasional (HP:0040283). (ORPHA:466650)
- Lethargy (HP:0001254): A state of fatigue, either physical or mental slowness and sluggishness, with difficulties in initiating or performing simple tasks. Distinguished from apathy which implies indifference and a lack of desire or interest in the task. A person with lethargy may have the desire, but not the energy to engage in personal or socially relevant tasks. Evidence: TAS. Frequency: Occasional (HP:0040283). (ORPHA:466650)
- Confusion (HP:0001289): Lack of clarity and coherence of thought, perception, understanding, or action. Evidence: TAS. Frequency: Occasional (HP:0040283). (ORPHA:466650)
- Muscle weakness (HP:0001324): Reduced strength of muscles. Evidence: TAS. Frequency: Occasional (HP:0040283). (ORPHA:466650)
- Decreased liver function (HP:0001410): Reduced ability of the liver to perform its functions. Evidence: TAS. Frequency: Occasional (HP:0040283). (ORPHA:466650)
- Prolonged QT interval (HP:0001657): Increased time between the start of the Q wave and the end of the T wave as measured by the electrocardiogram (EKG). Evidence: TAS. Frequency: Occasional (HP:0040283). (ORPHA:466650)
- Abnormal bleeding (HP:0001892): An abnormal susceptibility to bleeding, often referred to as a bleeding diathesis. A bleeding diathesis may be related to vascular, platelet and coagulation defects. Evidence: TAS. Frequency: Occasional (HP:0040283). (ORPHA:466650)
- Vomiting (HP:0002013): Forceful ejection of the contents of the stomach through the mouth by means of a series of involuntary spasmic contractions. Evidence: TAS. Frequency: Occasional (HP:0040283). (ORPHA:466650)
- Hyperkalemia (HP:0002153): The concentration of potassium(1+) in the blood circulation is above the upper limit of normal. Evidence: TAS. Frequency: Occasional (HP:0040283). (ORPHA:466650)
- Hypotension (HP:0002615): Low Blood Pressure, vascular hypotension. Evidence: TAS. Frequency: Occasional (HP:0040283). (ORPHA:466650)
- Hypocalcemia (HP:0002901): The concentration of calcium in the blood circulation is below the lower limit of normal. Evidence: TAS. Frequency: Occasional (HP:0040283). (ORPHA:466650)
- Hyperphosphatemia (HP:0002905): The concentration of phosphate ion in the blood circulation is above the upper limit of normal. Evidence: TAS. Frequency: Occasional (HP:0040283). (ORPHA:466650)
- Lactic acidosis (HP:0003128): An abnormal buildup of lactic acid in the body, leading to acidification of the blood and other bodily fluids. Evidence: TAS. Frequency: Occasional (HP:0040283). (ORPHA:466650)
- Elevated circulating creatine kinase activity (HP:0003236): The activity of creatine kinase in the blood circulation is above the upper limit of normal. Evidence: TAS. Frequency: Occasional (HP:0040283). (ORPHA:466650)
- Abnormality of the coagulation cascade (HP:0003256): An abnormality of the coagulation cascade, which is comprised of the contact activation pathway (also known as the intrinsic pathway) and the tissue factor pathway (also known as the extrinsic pathway) as well as cofactors and regulators. Evidence: TAS. Frequency: Occasional (HP:0040283). (ORPHA:466650)
- Exercise-induced muscle cramps (HP:0003710): Sudden and involuntary contractions of one or more muscles brought on by physical exertion. Evidence: TAS. Frequency: Occasional (HP:0040283). (ORPHA:466650)
- Abnormal T-wave (HP:0005135): An abnormality of the T wave on the electrocardiogram, which mainly represents the repolarization of the ventricles. Evidence: TAS. Frequency: Occasional (HP:0040283). (ORPHA:466650)
- ST segment depression (HP:0012250): An electrocardiographic anomaly in which the ST segment is observed to be located inferior to the isoelectric line. Evidence: TAS. Frequency: Occasional (HP:0040283). (ORPHA:466650)
- Hypocapnia (HP:0012417): Abnormally reduced blood carbon dioxide (CO2) level. Evidence: TAS. Frequency: Occasional (HP:0040283). (ORPHA:466650)
- Crackles (HP:0030830): Crackles are discontinuous, explosive, and nonmusical adventitious lung sounds normally heard in inspiration and sometimes during expiration. Crackles are usually classified as fine and coarse crackles based on their duration, loudness, pitch, timing in the respiratory cycle, and relationship to coughing and changing body position. Evidence: TAS. Frequency: Occasional (HP:0040283). (ORPHA:466650)
- Delirium (HP:0031258): A state of sudden and severe confusion. Evidence: TAS. Frequency: Occasional (HP:0040283). (ORPHA:466650)
- Flushing (HP:0031284): Recurrent episodes of redness of the skin together with a sensation of warmth or burning of the affected areas of skin. Evidence: TAS. Frequency: Occasional (HP:0040283). (ORPHA:466650)
- Oliguria (HP:0100520): Low output of urine, clinically classified as an output below 300-500ml/day. Evidence: TAS. Frequency: Occasional (HP:0040283). (ORPHA:466650)
- Dry skin (HP:0000958): Skin characterized by the lack of natural or normal moisture. Evidence: TAS. Frequency: Very rare (HP:0040284). (ORPHA:466650)
- Anhidrosis (HP:0000970): Inability to sweat. Evidence: TAS. Frequency: Very rare (HP:0040284). (ORPHA:466650)
- Hepatic failure (HP:0001399). Evidence: TAS. Frequency: Very rare (HP:0040284). (ORPHA:466650)
- Thrombocytopenia (HP:0001873): A reduction in the number of circulating thrombocytes. Evidence: TAS. Frequency: Very rare (HP:0040284). (ORPHA:466650)
- Acute kidney injury (HP:0001919): Sudden loss of renal function, as manifested by decreased urine production, and a rise in serum creatinine or blood urea nitrogen concentration (azotemia). Evidence: TAS. Frequency: Very rare (HP:0040284). (ORPHA:466650)
- Hepatic encephalopathy (HP:0002480): Central nervous system dysfunction in association with liver failure and characterized clinically (depending on degree of severity) by lethargy, confusion, nystagmus, decorticate posturing, spasticity, and bilateral Babinski reflexes. Evidence: TAS. Frequency: Very rare (HP:0040284). (ORPHA:466650)
- Rhabdomyolysis (HP:0003201): Breakdown of muscle fibers that leads to the release of muscle fiber contents (myoglobin) into the bloodstream. Evidence: TAS. Frequency: Very rare (HP:0040284). (ORPHA:466650)
- Disseminated intravascular coagulation (HP:0005521): Disseminated intravascular coagulation is characterized by the widespread activation of coagulation, which results in the intravascular formation of fibrin and ultimately thrombotic occlusion of small and midsize vessels. Evidence: TAS. Frequency: Very rare (HP:0040284). (ORPHA:466650)
These phenotypes are associated with the disease Exercise-induced malignant hyperthermia (ORPHA:466650).